Phenotypes associated with the disease cataract-nephropathy-encephalopathy syndrome (OMIM:218900):
- Microcephaly (HP:0000252): Head circumference below 2 standard deviations below the mean for age and gender. Evidence: PCS. Frequency: 2/2. (PMID:14065995)
- Short stature (HP:0004322): A height below that which is expected according to age and gender norms. Although there is no universally accepted definition of short stature, many refer to "short stature" as height more than 2 standard deviations below the mean for age and gender (or below the 3rd percentile for age and gender dependent norms). Evidence: PCS. (PMID:14065995)
- Nystagmus (HP:0000639): Rhythmic, involuntary oscillations of one or both eyes related to abnormality in fixation, conjugate gaze, or vestibular mechanisms. Evidence: PCS. Frequency: 1/2. Onset: Infantile onset (HP:0003593). (PMID:14065995)
- Seizure (HP:0001250): A seizure is an intermittent abnormality of nervous system physiology characterized by a transient occurrence of signs and/or symptoms due to abnormal excessive or synchronous neuronal activity in the brain. Evidence: PCS. Frequency: 2/2. Onset: Infantile onset (HP:0003593). (PMID:14065995)
- Renal tubular epithelial necrosis (HP:0008682): Coagulative necrosis of tubular epithelial cells, defined as cells with increased cytoplasmic eosinophilia and nucleus that has a condensed chromatin pattern with fuzzy nuclear contour or has barely visible nuclear basophilic staining. The extent of cortical tubular necrosis is scoredsemiquantitatively as none, mild (less than 25% tubules with necrosis), moderate (25-50 percent), and severe (over 50%). Evidence: PCS. Frequency: 2/2. (PMID:14065995)
- Cerebellar dysplasia (HP:0007033): Cerebellar dysplasia (abnormal growth or development) is defined by abnormal cerebellar foliation, white matter arborization, and gray-white matter junction. Cerebellar dysplasia is a neuroimaging finding that describes abnormalities of both the cerebellar cortex and white matter and is associated with variable neurodevelopmental outcome. Dysplasia may globally involve the cerebellum or affect only one cerebellar hemisphere. In addition, cerebellar dysplasia may be associated with cortical/subcortical cysts. Evidence: PCS. Frequency: 2/2. (PMID:14065995)
- Developmental cataract (HP:0000519): A cataract that occurs congenitally as the result of a developmental defect, in contrast to the majority of cataracts that occur in adulthood as the result of degenerative changes of the lens. Evidence: PCS. Frequency: 2/2. Onset: Congenital onset (HP:0003577). (PMID:14065995)
- Autosomal recessive inheritance (HP:0000007): A mode of inheritance that is observed for traits related to a gene encoded on one of the autosomes (i.e., the human chromosomes 1-22) in which a trait manifests in individuals with two pathogenic alleles, either homozygotes (two copies of the same mutant allele) or compound heterozygotes (whereby each copy of a gene has a distinct mutant allele). Evidence: PCS. (PMID:14065995)
- Severe global developmental delay (HP:0011344): A severe delay in the achievement of motor or mental milestones in the domains of development of a child. Evidence: PCS. Frequency: 2/2. Onset: Congenital onset (HP:0003577). (PMID:14065995)
- Intellectual disability (HP:0001249): The term intellectual disability or intellectual developmental disorder is used to describe significantly sub-average intellectual and adaptive functioning based on clinical assessment and as measured by individually administered, appropriately normed, standardized and validated tests of intellectual functioning and adaptive behavior, with onset during the developmental period from infancy through adolescence. Evidence: PCS. Frequency: 2/2. Onset: Infantile onset (HP:0003593). (PMID:14065995)